Phenotypes associated with the disease myoclonic dystonia 15 (OMIM:607488):
- Writer's cramp (HP:0002356): A focal dystonia of the fingers, hand, and/or forearm that appears when the affected person attempts to do a task that requires fine motor movements such as writing or playing a musical instrument. Evidence: IEA. (OMIM:607488)
- Dystonia (HP:0001332): An abnormally increased muscular tone that causes fixed abnormal postures. There is a slow, intermittent twisting motion that leads to exaggerated turning and posture of the extremities and trunk. Evidence: TAS. (OMIM:607488)
- Autosomal dominant inheritance (HP:0000006): A mode of inheritance that is observed for traits related to a gene encoded on one of the autosomes (i.e., the human chromosomes 1-22) in which a trait manifests in heterozygotes. In the context of medical genetics, an autosomal dominant disorder is caused when a single copy of the mutant allele is present. Males and females are affected equally, and can both transmit the disorder with a risk of 50% for each child of inheriting the mutant allele. Evidence: IEA. (OMIM:607488)
- Myoclonus (HP:0001336): Very brief, involuntary random muscular contractions occurring at rest, in response to sensory stimuli, or accompanying voluntary movements. Evidence: IEA. (OMIM:607488)